- Congenital onset (HP:0003577): A phenotypic abnormality that is present at birth. Evidence: PCS. Frequency: 24/24. (PMID:12845333)
- Dextrocardia (HP:0001651): The heart is located in the right hand sided hemithorax. That is, there is a left-right reversal (or "mirror reflection") of the anatomical location of the heart in which the heart is locate on the right side instead of the left. Evidence: PCS. Frequency: 1/24. (PMID:12845333)
- Ventricular septal defect (HP:0001629): A hole between the two bottom chambers (ventricles) of the heart. The defect is centered around the most superior aspect of the ventricular septum. Evidence: PCS. Frequency: 3/24. (PMID:12845333)
- Atrioventricular canal defect (HP:0006695): A defect of the atrioventricular septum of the heart. Evidence: PCS. Frequency: 1/24. (PMID:12845333)
- Aortic regurgitation (HP:0001659): An insufficiency of the aortic valve, leading to regurgitation (backward flow) of blood from the aorta into the left ventricle. Evidence: PCS. Frequency: 1/24. (PMID:12845333)
- Patent ductus arteriosus (HP:0001643): In utero, the ductus arteriosus (DA) serves to divert ventricular output away from the lungs and toward the placenta by connecting the main pulmonary artery to the descending aorta. A patent ductus arteriosus (PDA) in the first 3 days of life is a physiologic shunt in healthy term and preterm newborn infants, and normally is substantially closed within about 24 hours after bith and completely closed after about three weeks. Failure of physiologcal closure is referred to a persistent or patent ductus arteriosus (PDA). Depending on the degree of left-to-right shunting, PDA can have clinical consequences. Evidence: PCS. Frequency: 1/24. (PMID:12845333)
- Atrial septal defect (HP:0001631): Atrial septal defect (ASD) is a congenital abnormality of the interatrial septum that enables blood flow between the left and right atria via the interatrial septum. Evidence: PCS. Frequency: 23/24. (PMID:12845333)
- Mitral regurgitation (HP:0001653): An abnormality of the mitral valve characterized by insufficiency or incompetence of the mitral valve resulting in retrograde leaking of blood through the mitral valve upon ventricular contraction. Evidence: PCS. Frequency: 1/24. (PMID:12845333)
- Pulmonic stenosis (HP:0001642): A narrowing of the right ventricular outflow tract that can occur at the pulmonary valve (valvular stenosis), below the pulmonary valve (infundibular stenosis), or above the pulmonary valve (supravalvar stenosis). Evidence: PCS. Frequency: 6/24. (PMID:12845333)
- Autosomal dominant inheritance (HP:0000006): A mode of inheritance that is observed for traits related to a gene encoded on one of the autosomes (i.e., the human chromosomes 1-22) in which a trait manifests in heterozygotes. In the context of medical genetics, an autosomal dominant disorder is caused when a single copy of the mutant allele is present. Males and females are affected equally, and can both transmit the disorder with a risk of 50% for each child of inheriting the mutant allele. Evidence: PCS. (PMID:12845333)
These phenotypes are associated with the disease atrial septal defect 2 (OMIM:607941).